Phenotypes associated with the disease Nasolacrimal duct cyst (ORPHA:141083):
- Nasolacrimal duct obstruction (HP:0000579): Blockage of the lacrimal duct. Evidence: TAS. Frequency: Frequent (HP:0040282). (ORPHA:141083)
- Dacryocystitis (HP:0000620): Inflammation of the nasolacrimal sac. Evidence: TAS. Frequency: Frequent (HP:0040282). (ORPHA:141083)
- Nasal congestion (HP:0001742): Reduced ability to pass air through the nasal cavity often leading to mouth breathing. Evidence: TAS. Frequency: Frequent (HP:0040282). (ORPHA:141083)
- Epiphora (HP:0009926): Abnormally increased lacrimation, that is, excessive tearing (watering eye). Evidence: TAS. Frequency: Frequent (HP:0040282). (ORPHA:141083)
- Paroxysmal dyspnea (HP:0012763): A sudden attack of dyspnea that occurs while the affected person is at rest. Evidence: TAS. Frequency: Frequent (HP:0040282). (ORPHA:141083)
- Inappropriate crying (HP:0030215): Uncontrolled episodes of crying occur without any apparent motivating stimuli. Evidence: TAS. Frequency: Frequent (HP:0040282). (ORPHA:141083)
- Abnormal breath sound (HP:0030829): An anomalous (adventitious) sound produced by the breathing process. Evidence: TAS. Frequency: Frequent (HP:0040282). (ORPHA:141083)
- Abnormal lacrimal sac morphology (HP:3000066): An abnormality of a lacrimal sac. Evidence: TAS. Frequency: Frequent (HP:0040282). (ORPHA:141083)
- Amblyopia (HP:0000646): Reduced visual acuity that is uncorrectable by lenses in the absence of detectable anatomic defects in the eye or visual pathways. Evidence: TAS. Frequency: Occasional (HP:0040283). (ORPHA:141083)
- Fever (HP:0001945): Body temperature elevated above the normal range. Evidence: TAS. Frequency: Occasional (HP:0040283). (ORPHA:141083)
- Poor suck (HP:0002033): An inadequate sucking reflex, resulting in the difficult of newborns to be breast-fed. Evidence: TAS. Frequency: Occasional (HP:0040283). (ORPHA:141083)
- Recurrent infections (HP:0002719): Increased susceptibility to infections as manifested by repeated bouts of infection. Evidence: TAS. Frequency: Occasional (HP:0040283). (ORPHA:141083)
- Deviated nasal septum (HP:0004411): Positioning of the nasal septum to the right or left in contrast to the normal midline position of the nasal septum. Evidence: TAS. Frequency: Occasional (HP:0040283). (ORPHA:141083)
- Episodic respiratory distress (HP:0004885). Evidence: TAS. Frequency: Occasional (HP:0040283). (ORPHA:141083)
- Ectropion of lower eyelids (HP:0007651). Evidence: TAS. Frequency: Occasional (HP:0040283). (ORPHA:141083)
- Chronic irritative conjunctivitis (HP:0007717): A chronic irritative conjunctivitis, which commonly presents with general irritation and redness of the eyes, with a burning, dry, or foreign-body sensation of the eyes. Evidence: TAS. Frequency: Occasional (HP:0040283). (ORPHA:141083)
- Stridor (HP:0010307): Stridor is a high pitched sound resulting from turbulent air flow in the upper airway. Evidence: TAS. Frequency: Occasional (HP:0040283). (ORPHA:141083)
- Red eye (HP:0025337): A reddish appearance over the white part (sclera) of the eye ranging from a few enlarged blood vessels appearing as wiggly lines over the sclera to a bright red color completely covering to sclera. Evidence: TAS. Frequency: Occasional (HP:0040283). (ORPHA:141083)
- Corneal astigmatism (HP:0025612): A type of refractive error related abnormal curvatures on the anterior or posterior surface of the cornea. Evidence: TAS. Frequency: Occasional (HP:0040283). (ORPHA:141083)
- Dacryocystocele (HP:0030752): A nasolacrimal duct obstruction presenting as a grey-blue cystic swelling just below the medial canthus. Believed to be a result of concomitant upper obstruction of the Rosenmuller valve and lower obstruction of the Hasner valve. Evidence: TAS. Frequency: Occasional (HP:0040283). (ORPHA:141083)
- Intercostal retractions (HP:0030864): A pulling inward of the soft tissues between the ribs upon inhalation. This is a sign of increased use of the chest muscles for breathing and is a manifestation of respiratory distress. Evidence: TAS. Frequency: Occasional (HP:0040283). (ORPHA:141083)
- Narrow palpebral fissure (HP:0045025): Reduction in the vertical distance between the upper and lower eyelids. Evidence: TAS. Frequency: Occasional (HP:0040283). (ORPHA:141083)
- Periorbital edema (HP:0100539): Edema affecting the region situated around the orbit of the eye. Evidence: TAS. Frequency: Occasional (HP:0040283). (ORPHA:141083)
- Cellulitis (HP:0100658): A bacterial infection and inflammation of the skin und subcutaneous tissues. Evidence: TAS. Frequency: Occasional (HP:0040283). (ORPHA:141083)
- Ocular pain (HP:0200026): An unpleasant sensation characterized by physical discomfort (such as pricking, throbbing, or aching) localized to the eye. Evidence: TAS. Frequency: Occasional (HP:0040283). (ORPHA:141083)